Phenotypes associated with the disease FINGERS, RELATIVE LENGTH OF (OMIM:136100):
- Short 2nd finger (HP:0009536): Hypoplasia of the second finger, also known as the index finger. Evidence: IEA. (OMIM:136100)
- Autosomal dominant inheritance (HP:0000006): A mode of inheritance that is observed for traits related to a gene encoded on one of the autosomes (i.e., the human chromosomes 1-22) in which a trait manifests in heterozygotes. In the context of medical genetics, an autosomal dominant disorder is caused when a single copy of the mutant allele is present. Males and females are affected equally, and can both transmit the disorder with a risk of 50% for each child of inheriting the mutant allele. Evidence: IEA. (OMIM:136100)